Phenotypes associated with the disease spastic paraplegia 90B, autosomal recessive (OMIM:620417):
- Axial hypotonia (HP:0008936): Muscular hypotonia (abnormally low muscle tone) affecting the musculature of the trunk. Evidence: PCS. Frequency: 0/1. (PMID:36718090)
- Dysphagia (HP:0002015): Difficulty in swallowing. Evidence: PCS. Frequency: 0/1. (PMID:36718090)
- Absent speech (HP:0001344): Complete lack of development of speech and language abilities. Evidence: PCS. Frequency: 0/1. (PMID:36718090)
- Tethered cord (HP:0002144): During normal embryological development, the spinal cord first occupies the entire length of the vertebral column but goes on to assume a position at the level of L1 due to differential growth of the conus medullaris and the vertebral column. The filum terminale is a slender, threadlike structure that remains after the normal regression of the distal embryonic spinal cord and attaches the spinal cord to the coccyx. A tethered cord results if there is a thickened rope-like filum terminale which anchors the cord at the level of L2 or below, potentially causing neurologic signs owing to abnormal tension on the spinal cord. Evidence: PCS. Frequency: 0/1. (PMID:36718090)
- Short stature (HP:0004322): A height below that which is expected according to age and gender norms. Although there is no universally accepted definition of short stature, many refer to "short stature" as height more than 2 standard deviations below the mean for age and gender (or below the 3rd percentile for age and gender dependent norms). Evidence: PCS. Frequency: 1/1. (PMID:36718090)
- Delayed ability to walk (HP:0031936): A failure to achieve the ability to walk at an appropriate developmental stage. Most children learn to walk in a series of stages, and learn to walk short distances independently between 12 and 15 months. Evidence: PCS. Frequency: 1/1. (PMID:36718090)
- Dystonia (HP:0001332): An abnormally increased muscular tone that causes fixed abnormal postures. There is a slow, intermittent twisting motion that leads to exaggerated turning and posture of the extremities and trunk. Evidence: PCS. Frequency: 0/1. (PMID:36718090)
- Seizure (HP:0001250): A seizure is an intermittent abnormality of nervous system physiology characterized by a transient occurrence of signs and/or symptoms due to abnormal excessive or synchronous neuronal activity in the brain. Evidence: PCS. Frequency: 1/1. (PMID:36718090)
- Sleep disturbance (HP:0002360): An abnormal pattern in the quality, quantity, or characteristics of sleep. Evidence: PCS. Frequency: 0/1. (PMID:36718090)
- Gastroesophageal reflux (HP:0002020): A condition in which the stomach contents leak backwards from the stomach into the esophagus through the lower esophageal sphincter. Evidence: PCS. Frequency: 1/1. (PMID:36718090)
- Infantile onset (HP:0003593): Onset of signs or symptoms of disease between 28 days to one year of life. Evidence: PCS. Frequency: 1/1. (PMID:36718090)
- Joint contracture (HP:0034392): A limitation in the passive range of motion of a joint resulting from loss of elasticity in the periarticular tissues owing to structural changes of non-bony tissues, such as muscles, tendons, ligaments, joint capsules or skin. A contracture prevents movement of the associated body part. Evidence: PCS. Frequency: 1/1. (PMID:36718090)
- Failure to thrive (HP:0001508): Failure to thrive (FTT) refers to a child whose physical growth is substantially below the norm. Evidence: PCS. Frequency: 1/1. (PMID:36718090)
- Appendicular spasticity (HP:0034353): A type of spasticity that affects one or more limbs (arms or legs). Evidence: PCS. Frequency: 1/1. (PMID:36718090)
- Sensorineural hearing impairment (HP:0000407): A type of hearing impairment in one or both ears related to an abnormal functionality of the cochlear nerve. Evidence: PCS. Frequency: 1/1. (PMID:36718090)
- Autosomal recessive inheritance (HP:0000007): A mode of inheritance that is observed for traits related to a gene encoded on one of the autosomes (i.e., the human chromosomes 1-22) in which a trait manifests in individuals with two pathogenic alleles, either homozygotes (two copies of the same mutant allele) or compound heterozygotes (whereby each copy of a gene has a distinct mutant allele). Evidence: PCS. (PMID:36718090)
- Drooling (HP:0002307): Habitual flow of saliva out of the mouth. Evidence: PCS. Frequency: 0/1. (PMID:36718090)
- Macrocephaly (HP:0000256): Occipitofrontal (head) circumference greater than 97th centile compared to appropriate, age matched, sex-matched normal standards. Alternatively, a apparently increased size of the cranium. Evidence: PCS. Frequency: 0/1. (PMID:36718090)
- Myopia (HP:0000545): An abnormality of refraction characterized by the ability to see objects nearby clearly, while objects in the distance appear blurry. Evidence: PCS. Frequency: 1/1. (PMID:36718090)
- Intellectual disability (HP:0001249): The term intellectual disability or intellectual developmental disorder is used to describe significantly sub-average intellectual and adaptive functioning based on clinical assessment and as measured by individually administered, appropriately normed, standardized and validated tests of intellectual functioning and adaptive behavior, with onset during the developmental period from infancy through adolescence. Evidence: PCS. Frequency: 0/1. (PMID:36718090)